Phenotypes associated with the disease COG8-CDG (ORPHA:95428):
- Intellectual disability (HP:0001249): The term intellectual disability or intellectual developmental disorder is used to describe significantly sub-average intellectual and adaptive functioning based on clinical assessment and as measured by individually administered, appropriately normed, standardized and validated tests of intellectual functioning and adaptive behavior, with onset during the developmental period from infancy through adolescence. Evidence: TAS. Frequency: Frequent (HP:0040282). (ORPHA:95428)
- Seizure (HP:0001250): A seizure is an intermittent abnormality of nervous system physiology characterized by a transient occurrence of signs and/or symptoms due to abnormal excessive or synchronous neuronal activity in the brain. Evidence: TAS. Frequency: Frequent (HP:0040282). (ORPHA:95428)
- Ataxia (HP:0001251): Ataxia refers to impaired coordination of voluntary muscle movement. Cerebellar ataxia refers to ataxia due to dysfunction of the cerebellum. This causes a variety of elementary neurological deficits including asynergy (lack of coordination between muscles, limbs and joints), dysmetria (lack of ability to judge distances that can lead to under- or overshoot in grasping movements), and dysdiadochokinesia (inability to perform rapid movements requiring antagonizing muscle groups to be switched on and off repeatedly). Evidence: TAS. Frequency: Frequent (HP:0040282). (ORPHA:95428)
- Failure to thrive (HP:0001508): Failure to thrive (FTT) refers to a child whose physical growth is substantially below the norm. Evidence: TAS. Frequency: Frequent (HP:0040282). (ORPHA:95428)
- Protein-losing enteropathy (HP:0002243): Abnormal loss of protein from the digestive tract related to excessive leakage of plasma proteins into the lumen of the gastrointestinal tract. Evidence: TAS. Frequency: Frequent (HP:0040282). (ORPHA:95428)
- Developmental regression (HP:0002376): Loss of developmental skills, as manifested by loss of developmental milestones. Evidence: TAS. Frequency: Frequent (HP:0040282). (ORPHA:95428)
- Poor head control (HP:0002421): Difficulty to maintain correct position of the head while standing or sitting. Infant head lag is observed when the head seems to flop around or lags posteriorly behind the trunk. Several articles have maintained that head lag should be absent by age 3 to 4 months. Evidence: TAS. Frequency: Frequent (HP:0040282). (ORPHA:95428)
- Poor speech (HP:0002465). Evidence: TAS. Frequency: Frequent (HP:0040282). (ORPHA:95428)
- Skeletal muscle atrophy (HP:0003202): The presence of skeletal muscular atrophy (which is also known as amyotrophy). Evidence: TAS. Frequency: Frequent (HP:0040282). (ORPHA:95428)
- Chronic axonal neuropathy (HP:0007267): An abnormality characterized by chronic impairment of the normal functioning of the axons. Evidence: TAS. Frequency: Frequent (HP:0040282). (ORPHA:95428)
- Floppy infant (HP:0008947): Floppiness/hypotonia is defined as reduced resistance to passive movement of joints. Physical examination of floppy/hypotonic infants shows head lag, lack of shoulder and elbow muscle contraction on traction response, inability to tighten the shoulder girdle muscles (or slipping through) when held under the axillae, scarf sign (when the arm is pulled to the opposite side, the arm wraps around the neck with the elbow crossing midline), hyperdorsiflexion of the feet, easy apposition of the thumb against the forearm, feet touching the cheek with ease and without discomfort, frog leg position, and inverted U sign on ventral suspension (head, arms, and legs hanging down without elbow or knee flexion and the trunk rounded in a dome shape). Evidence: TAS. Frequency: Frequent (HP:0040282). (ORPHA:95428)
- Severe global developmental delay (HP:0011344): A severe delay in the achievement of motor or mental milestones in the domains of development of a child. Evidence: TAS. Frequency: Frequent (HP:0040282). (ORPHA:95428)
- Food intolerance (HP:0012537): A detrimental reaction to a food, beverage, food additive, or compound found in foods that produces symptoms in one or more body organs and systems that is not mediated by an immune reaction. Evidence: TAS. Frequency: Frequent (HP:0040282). (ORPHA:95428)
- Progressive microcephaly (HP:0000253): Progressive microcephaly is diagnosed when the head circumference falls progressively behind age- and gender-dependent norms. Evidence: TAS. Frequency: Occasional (HP:0040283). (ORPHA:95428)
- Alternating esotropia (HP:0001137): Esotropia in which either eye may be used for fixation. Evidence: TAS. Frequency: Occasional (HP:0040283). (ORPHA:95428)
- Cerebellar atrophy (HP:0001272): Cerebellar atrophy is defined as a cerebellum with initially normal structures, in a posterior fossa with normal size, which displays enlarged fissures (interfolial spaces) in comparison to the foliae secondary to loss of tissue. Cerebellar atrophy implies irreversible loss of tissue and result from an ongoing progressive disease until a final stage is reached or a single injury, e.g. an intoxication or infectious event. Evidence: TAS. Frequency: Occasional (HP:0040283). (ORPHA:95428)
- Myoclonus (HP:0001336): Very brief, involuntary random muscular contractions occurring at rest, in response to sensory stimuli, or accompanying voluntary movements. Evidence: TAS. Frequency: Occasional (HP:0040283). (ORPHA:95428)
- Hypoglycemia (HP:0001943): A decreased concentration of glucose in the blood. Evidence: TAS. Frequency: Occasional (HP:0040283). (ORPHA:95428)
- Ventriculomegaly (HP:0002119): An increase in size of the ventricular system of the brain. Evidence: TAS. Frequency: Occasional (HP:0040283). (ORPHA:95428)
- Elevated circulating hepatic transaminase concentration (HP:0002910): Elevations of the levels of SGOT and SGPT in the serum. SGOT (serum glutamic oxaloacetic transaminase) and SGPT (serum glutamic pyruvic transaminase) are transaminases primarily found in the liver and heart and are released into the bloodstream as the result of liver or heart damage. SGOT and SGPT are used clinically mainly as markers of liver damage. Evidence: TAS. Frequency: Occasional (HP:0040283). (ORPHA:95428)
- Acute encephalopathy (HP:0006846). Evidence: TAS. Frequency: Occasional (HP:0040283). (ORPHA:95428)
- Atrophy/Degeneration affecting the brainstem (HP:0007366). Evidence: TAS. Frequency: Occasional (HP:0040283). (ORPHA:95428)
- Spontaneous hematomas (HP:0007420): Spontaneous development of hematomas (hematoma) or bruises without significant trauma. Evidence: TAS. Frequency: Occasional (HP:0040283). (ORPHA:95428)
- Prolonged prothrombin time (HP:0008151): Increased time to coagulation in the prothrombin time test, which is a measure of the extrinsic pathway of coagulation. The results of the prothrombin time test are often expressed in terms of the International normalized ratio (INR), which is calculated as a ratio of the patient's prothrombin time (PT) to a control PT standardized for the potency of the thromboplastin reagent developed by the World Health Organization (WHO) using the formula: INR is equal to Patient PT divided by Control PT. Evidence: TAS. Frequency: Occasional (HP:0040283). (ORPHA:95428)